Phenotypes associated with the disease microcephaly and chorioretinopathy 2 (OMIM:616171):
- Congenital onset (HP:0003577): A phenotypic abnormality that is present at birth. Evidence: TAS. (OMIM:616171)
- Sloping forehead (HP:0000340): Inclination of the anterior surface of the forehead from the vertical more than two standard deviations above the mean (objective); or apparently excessive posterior sloping of the forehead in a lateral view. Evidence: TAS. (OMIM:616171)
- Short stature (HP:0004322): A height below that which is expected according to age and gender norms. Although there is no universally accepted definition of short stature, many refer to "short stature" as height more than 2 standard deviations below the mean for age and gender (or below the 3rd percentile for age and gender dependent norms). Evidence: PCS. Frequency: 6/6. (PMID:25344692)
- Cerebellar atrophy (HP:0001272): Cerebellar atrophy is defined as a cerebellum with initially normal structures, in a posterior fossa with normal size, which displays enlarged fissures (interfolial spaces) in comparison to the foliae secondary to loss of tissue. Cerebellar atrophy implies irreversible loss of tissue and result from an ongoing progressive disease until a final stage is reached or a single injury, e.g. an intoxication or infectious event. Evidence: TAS. (OMIM:616171)
- Seizure (HP:0001250): A seizure is an intermittent abnormality of nervous system physiology characterized by a transient occurrence of signs and/or symptoms due to abnormal excessive or synchronous neuronal activity in the brain. Evidence: PCS. Frequency: 1/7. (PMID:25344692)
- Microcornea (HP:0000482): A congenital abnormality of the cornea in which the cornea and the anterior segment of the eye are smaller than normal. The horizontal diameter of the cornea does not reach 10 mm even in adulthood. Evidence: PCS. Frequency: 2/7. (PMID:25344692)
- Hypoplasia of the pons (HP:0012110): Underdevelopment of the pons. Evidence: PCS. Frequency: 2/7. (PMID:25344692)
- Cataract (HP:0000518): A cataract is an opacity or clouding that develops in the crystalline lens of the eye or in its capsule. Evidence: PCS. Frequency: 2/7. (PMID:25344692)
- Periventricular heterotopia (HP:0007165): A form of gray matter heterotopia were the mislocalized gray matter is typically located periventricularly, also sometimes called subependymal heterotopia. Periventricular means beside the ventricles. This is by far the most common location for heterotopia. Subependymal heterotopia present in a wide array of variations. There can be a small single node or a large number of nodes, can exist on either or both sides of the brain at any point along the higher ventricle margins, can be small or large, single or multiple, and can form a small node or a large wavy or curved mass. Evidence: PCS. Frequency: 1/7. (PMID:25344692)
- Arachnoid cyst (HP:0100702): An extra-parenchymal and intra-arachnoidal collection of fluid with a composition similar to that of cerebrospinal fluid. Evidence: PCS. Frequency: 2/7. (PMID:25344692)
- Macular atrophy (HP:0007401): A nonspecific term denoting wasting, especially as a result of degeneration, of the retinal pigment epithelium (RPE) and neurosensory retinal cells in the macula. Evidence: TAS. Frequency: Occasional (HP:0040283). (OMIM:616171)
- Intellectual disability (HP:0001249): The term intellectual disability or intellectual developmental disorder is used to describe significantly sub-average intellectual and adaptive functioning based on clinical assessment and as measured by individually administered, appropriately normed, standardized and validated tests of intellectual functioning and adaptive behavior, with onset during the developmental period from infancy through adolescence. Evidence: PCS. Frequency: 7/7. (PMID:25344692)
- Cerebral atrophy (HP:0002059): Atrophy (wasting, decrease in size of cells or tissue) affecting the cerebrum. Evidence: TAS. (OMIM:616171)
- Microcephaly (HP:0000252): Head circumference below 2 standard deviations below the mean for age and gender. Evidence: PCS. Frequency: 7/7. (PMID:25344692)
- Absent speech (HP:0001344): Complete lack of development of speech and language abilities. Evidence: PCS. Frequency: 4/7. (PMID:25344692)
- Talipes equinovarus (HP:0001762): Talipes equinovarus (also called clubfoot) typically has four main components: inversion and adduction of the forefoot; inversion of the heel and hindfoot; equinus (limitation of extension) of the ankle and subtalar joint; and internal rotation of the leg. Evidence: PCS. Frequency: 1/7. (PMID:25344692)
- Cerebellar hypoplasia (HP:0001321): Cerebellar hypoplasia is a descriptive term implying a cerebellum with a reduced volume, but a normal shape and is stable over time. Evidence: PCS. Frequency: 2/7. (PMID:25344692)
- Global developmental delay (HP:0001263): A delay in the achievement of motor or mental milestones in the domains of development of a child, including motor skills, speech and language, cognitive skills, and social and emotional skills. This term should only be used to describe children younger than five years of age. Evidence: TAS. (OMIM:616171)
- Prominent nose (HP:0000448): Distance between subnasale and pronasale more than two standard deviations above the mean, or alternatively, an apparently increased anterior protrusion of the nasal tip. Evidence: TAS. Frequency: Occasional (HP:0040283). (OMIM:616171)
- Autosomal recessive inheritance (HP:0000007): A mode of inheritance that is observed for traits related to a gene encoded on one of the autosomes (i.e., the human chromosomes 1-22) in which a trait manifests in individuals with two pathogenic alleles, either homozygotes (two copies of the same mutant allele) or compound heterozygotes (whereby each copy of a gene has a distinct mutant allele). Evidence: PCS. (PMID:25344692)
- Microphthalmia (HP:0000568): A developmental anomaly characterized by abnormal smallness of one or both eyes. Evidence: TAS. (OMIM:616171)
- Partial agenesis of the corpus callosum (HP:0001338): A partial failure of the development of the corpus callosum. Evidence: PCS. Frequency: 2/7. (PMID:25344692)
- Optic atrophy (HP:0000648): Atrophy of the optic nerve. Optic atrophy results from the death of the retinal ganglion cell axons that comprise the optic nerve and manifesting as a pale optic nerve on fundoscopy. Evidence: TAS. Frequency: Occasional (HP:0040283). (OMIM:616171)
- Visual impairment (HP:0000505): Visual impairment (or vision impairment) is vision loss (of a person) to such a degree as to qualify as an additional support need through a significant limitation of visual capability resulting from either disease, trauma, or congenital or degenerative conditions that cannot be corrected by conventional means, such as refractive correction, medication, or surgery. Evidence: TAS. (OMIM:616171)
- Intrauterine growth retardation (HP:0001511): An abnormal restriction of fetal growth with fetal weight below the tenth percentile for gestational age. Evidence: PCS. Frequency: 1/7. (PMID:25344692)
- Lumbar scoliosis (HP:0004626). Evidence: PCS. Frequency: 1/7. (PMID:25344692)
- Optic disc pallor (HP:0000543): A pale yellow discoloration of the optic disc (the area of the optic nerve head in the retina). The optic disc normally has a pinkish hue with a central yellowish depression. Evidence: TAS. Frequency: Occasional (HP:0040283). (OMIM:616171)
- Retinopathy (HP:0000488): Any noninflammatory disease of the retina. This nonspecific term is retained here because of its wide use in the literature, but if possible new annotations should indicate the precise type of retinal abnormality. Evidence: TAS. Frequency: Occasional (HP:0040283). (OMIM:616171)
- Proptosis (HP:0000520): An eye that is protruding anterior to the plane of the face to a greater extent than is typical. Evidence: TAS. Frequency: Occasional (HP:0040283). (OMIM:616171)
- Thoracic scoliosis (HP:0002943). Evidence: PCS. Frequency: 1/7. (PMID:25344692)
- Micrognathia (HP:0000347): Developmental hypoplasia of the mandible. Evidence: PCS. Frequency: 2/7. (PMID:25344692)
- Simplified gyral pattern (HP:0009879): An abnormality of the cerebral cortex with fewer gyri but with normal cortical thickness. This pattern is usually often associated with congenital microcephaly. Evidence: TAS. (OMIM:616171)